Phenotypes associated with the disease nasopharyngeal carcinoma, susceptibility to, 2 (OMIM:161550):
- Neoplasia of the nasopharynx (HP:0100630). Evidence: TAS. (OMIM:161550)